Phenotypes associated with the disease ataxia - intellectual disability - oculomotor apraxia - cerebellar cysts syndrome (OMIM:615960):
- Cerebellar vermis hypoplasia (HP:0001320): Underdevelopment of the vermis of cerebellum. Evidence: TAS. (OMIM:615960)
- Strabismus (HP:0000486): A misalignment of the eyes so that the visual axes deviate from bifoveal fixation. The classification of strabismus may be based on a number of features including the relative position of the eyes, whether the deviation is latent or manifest, intermittent or constant, concomitant or otherwise and according to the age of onset and the relevance of any associated refractive error. Evidence: TAS. (OMIM:615960)
- Delayed speech and language development (HP:0000750): A degree of language development that is significantly below the norm for a child of a specified age. Evidence: TAS. (OMIM:615960)
- Dilated fourth ventricle (HP:0002198): An abnormal dilatation of the fourth cerebral ventricle. Evidence: TAS. (OMIM:615960)
- Hypotonia (HP:0001252): Hypotonia is an abnormally low muscle tone (the amount of tension or resistance to movement in a muscle). Even when relaxed, muscles have a continuous and passive partial contraction which provides some resistance to passive stretching. Hypotonia thus manifests as diminished resistance to passive stretching. Hypotonia is not the same as muscle weakness, although the two conditions can co-exist. Evidence: TAS. Frequency: Occasional (HP:0040283). (OMIM:615960)
- Cerebellar cyst (HP:0002350). Evidence: TAS. (OMIM:615960)
- Generalized hypotonia (HP:0001290): Generalized muscular hypotonia (abnormally low muscle tone). Evidence: TAS. Frequency: Occasional (HP:0040283). (OMIM:615960)
- Gray matter heterotopia (HP:0002282): Heterotopia or neuronal heterotopia are macroscopic clusters of misplaced neurons (gray matter), most often situated along the ventricular walls or within the subcortical white matter. Evidence: IEA. (OMIM:615960)
- Motor delay (HP:0001270): A type of Developmental delay characterized by a delay in acquiring motor skills. Evidence: TAS. (OMIM:615960)
- Retinal thinning on OCT (HP:0030329): Reduced anteroposterior thickness of the retina. This phenotype can be appreciated by retinal optical coherence tomography (OCT). Evidence: PCS. (PMID:25105227)
- Nystagmus (HP:0000639): Rhythmic, involuntary oscillations of one or both eyes related to abnormality in fixation, conjugate gaze, or vestibular mechanisms. Evidence: TAS. (OMIM:615960)
- Cerebellar dysplasia (HP:0007033): Cerebellar dysplasia (abnormal growth or development) is defined by abnormal cerebellar foliation, white matter arborization, and gray-white matter junction. Cerebellar dysplasia is a neuroimaging finding that describes abnormalities of both the cerebellar cortex and white matter and is associated with variable neurodevelopmental outcome. Dysplasia may globally involve the cerebellum or affect only one cerebellar hemisphere. In addition, cerebellar dysplasia may be associated with cortical/subcortical cysts. Evidence: TAS. (OMIM:615960)
- Variable expressivity (HP:0003828): A variable severity of phenotypic features. Evidence: TAS. (OMIM:615960)
- Amblyopia (HP:0000646): Reduced visual acuity that is uncorrectable by lenses in the absence of detectable anatomic defects in the eye or visual pathways. Evidence: TAS. (OMIM:615960)
- Oculomotor apraxia (HP:0000657): Ocular motor apraxia is a deficiency in voluntary, horizontal, lateral, fast eye movements (saccades) with retention of slow pursuit movements. The inability to follow objects visually is often compensated by head movements. There may be decreased smooth pursuit, and cancelation of the vestibulo-ocular reflex. Evidence: TAS. (OMIM:615960)
- Abnormal periventricular white matter morphology (HP:0002518): A structural abnormality of the myelinated axons (white matter) located near the cerebral ventricles. Evidence: TAS. (OMIM:615960)
- Autosomal recessive inheritance (HP:0000007): A mode of inheritance that is observed for traits related to a gene encoded on one of the autosomes (i.e., the human chromosomes 1-22) in which a trait manifests in individuals with two pathogenic alleles, either homozygotes (two copies of the same mutant allele) or compound heterozygotes (whereby each copy of a gene has a distinct mutant allele). Evidence: TAS. (OMIM:615960)
- Myopia (HP:0000545): An abnormality of refraction characterized by the ability to see objects nearby clearly, while objects in the distance appear blurry. Evidence: TAS. (OMIM:615960)
- Retinal dystrophy (HP:0000556): Retinal dystrophy is an abnormality of the retina associated with a hereditary process. Retinal dystrophies are defined by their predominantly monogenic inheritance and they are frequently associated with loss or dysfunction of photoreceptor cells as a primary or secondary event. Evidence: TAS. (OMIM:615960)
- Retinal atrophy (HP:0001105): A nonspecific term denoting wasting, especially as a result of degeneration, of the retinal pigment epithelium (RPE) and neurosensory retinal cells. Evidence: TAS. (OMIM:615960)